- X-linked recessive inheritance (HP:0001419): A mode of inheritance that is observed for recessive traits related to a gene encoded on the X chromosome. In the context of medical genetics, X-linked recessive disorders manifest in males (who have one copy of the X chromosome and are thus hemizygotes), but generally not in female heterozygotes who have one mutant and one normal allele. Evidence: TAS. (OMIM:313000)
- Abnormality of the nervous system (HP:0000707): An abnormality of the nervous system. Evidence: IEA. (OMIM:313000)
These phenotypes are associated with the disease spatial visualization, aptitude for (OMIM:313000).